- Woolly hair (HP:0002224): The term wooly hair refers to an abnormal variant of hair that is fine, with tightly coiled curls, and often hypopigmented. Optical microscopy may reveal the presence of tight spirals and a clear diameter reduction as compared with normal hair. Electron microscopy may show flat, oval hair shafts with reduced transversal diameter. Evidence: TAS. (OMIM:278200)
- Everted lower lip vermilion (HP:0000232): An abnormal configuration of the lower lip such that it is turned outward i.e., everted, with the Inner aspect of the lower lip vermilion (normally opposing the teeth) being visible in a frontal view. Evidence: TAS. (OMIM:278200)
- Autosomal recessive inheritance (HP:0000007): A mode of inheritance that is observed for traits related to a gene encoded on one of the autosomes (i.e., the human chromosomes 1-22) in which a trait manifests in individuals with two pathogenic alleles, either homozygotes (two copies of the same mutant allele) or compound heterozygotes (whereby each copy of a gene has a distinct mutant allele). Evidence: TAS. (OMIM:278200)
- Protruding ear (HP:0000411): Angle formed by the plane of the ear and the mastoid bone greater than the 97th centile for age (objective); or, outer edge of the helix more than 2 cm from the mastoid at the point of maximum distance (objective). Evidence: TAS. (OMIM:278200)
- Sparse hair (HP:0008070): Reduced density of hairs. Evidence: TAS. (OMIM:278200)
These phenotypes are associated with the disease wooly hair-hypotrichosis-everted lower lip-outstanding ears syndrome (OMIM:278200).